Phenotypes associated with the disease intellectual developmental disorder 60 with seizures (OMIM:618587):
- Bilateral tonic-clonic seizure (HP:0002069): A bilateral tonic-clonic seizure is a seizure defined by a tonic (bilateral increased tone, lasting seconds to minutes) and then a clonic (bilateral sustained rhythmic jerking) phase. Evidence: PCS. Frequency: 1/4. (PMID:31104773)
- Truncal ataxia (HP:0002078): Truncal ataxia is a sign of ataxia characterized by instability of the trunk. It usually occurs during sitting. Evidence: PCS. Frequency: 3/4. (PMID:31104773)
- Focal impaired awareness seizure (HP:0002384): Focal impaired awareness seizure (or focal seizure with impaired or lost awareness) is a type of focal-onset seizure characterized by some degree (which may be partial) of impairment of the person's awareness of themselves or their surroundings at any point during the seizure. Evidence: PCS. Frequency: 1/4. (PMID:31104773)
- Atonic seizure (HP:0010819): Atonic seizure is a type of motor seizure characterized by a sudden loss or diminution of muscle tone without apparent preceding myoclonic or tonic event lasting about 1 to 2 seconds, involving head, trunk, jaw, or limb musculature. Evidence: IEA. Frequency: 2/4. (PMID:31104773)
- Gait ataxia (HP:0002066): A type of ataxia characterized by the impairment of the ability to coordinate the movements required for normal walking. Gait ataxia is characteirzed by a wide-based staggering gait with a tendency to fall. Evidence: PCS. Frequency: 3/4. (PMID:31104773)
- Absence seizure with eyelid myoclonia (HP:0011149): An absence with eyelid myoclonia seizure is a type of generalized non-motor (absence) seizure characterized by forced upward jerking of the eyelids during an absence seizure. Evidence: PCS. Frequency: 2/4. (PMID:31104773)
- Generalized hypotonia (HP:0001290): Generalized muscular hypotonia (abnormally low muscle tone). Evidence: PCS. Frequency: 4/4. (PMID:31104773)
- Chorea (HP:0002072): Chorea (Greek for 'dance') refers to widespread arrhythmic involuntary movements of a forcible, jerky and restless fashion. It is a random-appearing sequence of one or more discrete involuntary movements or movement fragments. Movements appear random because of variability in timing, duration or location. Each movement may have a distinct start and end. However, movements may be strung together and thus may appear to flow randomly from one muscle group to another. Chorea can involve the trunk, neck, face, tongue, and extremities. Evidence: PCS. Frequency: 1/4. (PMID:31104773)
- EEG with polyspike wave complexes (HP:0002392): The presence of complexes of repetitive spikes and waves in EEG. Evidence: PCS. Frequency: 1/4. (PMID:31104773)
- EEG with spike-wave complexes (HP:0010850): Complexes of spikes (<70 ms) and sharp waves (70-200 ms), which are sharp transient waves that have a strong association with epilepsy, in cerebral electrical activity recorded along the scalp by electroencephalography (EEG). Evidence: PCS. Frequency: 2/4. (PMID:31104773)
- Atypical absence seizure (HP:0007270): An atypical absence seizure is a type of generalized non-motor (absence) seizure characterized by interruption of ongoing activities and reduced responsiveness. In comparison to a typical absence seizure, changes in tone may be more pronounced, onset and/or cessation may be less abrupt, and the duration of the ictus and post-ictal recovery may be longer. Although not always available, an EEG often demonstrates slow (<3 Hz), irregular, generalized spike-wave activity. Evidence: PCS. Frequency: 2/4. (PMID:31104773)
- Autistic behavior (HP:0000729): Persistent deficits in social interaction and communication and interaction as well as a markedly restricted repertoire of activity and interest as well as repetitive patterns of behavior. Evidence: PCS. Frequency: 2/4. (PMID:31104773)
- Hyperplasia of the maxilla (HP:0430028): Abnormally increased dimension of the maxilla, especially relative to the mandible, resulting in a malocclusion or malalignment between the upper and lower teeth or in anterior positioning of the nasal base, increased convexity of the face, increased nasolabial angle, or increased width (transverse dimension of the maxilla. Evidence: PCS. Frequency: 1/4. (PMID:31104773)
- Thin upper lip vermilion (HP:0000219): Height of the vermilion of the upper lip in the midline more than 2 SD below the mean. Alternatively, an apparently reduced height of the vermilion of the upper lip in the frontal view (subjective). Evidence: PCS. Frequency: 1/4. (PMID:31104773)
- Generalized myoclonic-atonic seizure (HP:0011170): A generalized myoclonic-atonic seizure is a type of generalized motor seizure characterized by a myoclonic jerk followed by an atonic motor component. Evidence: PCS. Frequency: 1/4. (PMID:31104773)
- Autosomal dominant inheritance (HP:0000006): A mode of inheritance that is observed for traits related to a gene encoded on one of the autosomes (i.e., the human chromosomes 1-22) in which a trait manifests in heterozygotes. In the context of medical genetics, an autosomal dominant disorder is caused when a single copy of the mutant allele is present. Males and females are affected equally, and can both transmit the disorder with a risk of 50% for each child of inheriting the mutant allele. Evidence: PCS. (PMID:31104773)
- Intellectual disability (HP:0001249): The term intellectual disability or intellectual developmental disorder is used to describe significantly sub-average intellectual and adaptive functioning based on clinical assessment and as measured by individually administered, appropriately normed, standardized and validated tests of intellectual functioning and adaptive behavior, with onset during the developmental period from infancy through adolescence. Evidence: PCS. Frequency: 4/4. (PMID:31104773)
- Tremor (HP:0001337): An unintentional, oscillating to-and-fro muscle movement about a joint axis. Evidence: PCS. Frequency: 1/4. (PMID:31104773)
- Abnormal cerebral white matter morphology (HP:0002500): An abnormality of the cerebral white matter. Evidence: PCS. Frequency: 1/4. (PMID:31104773)
- Myoclonus (HP:0001336): Very brief, involuntary random muscular contractions occurring at rest, in response to sensory stimuli, or accompanying voluntary movements. Evidence: PCS. Frequency: 1/4. (PMID:31104773)